- Subcutaneous nodule (HP:0001482): Slightly elevated lesions on or in the skin with a diameter of over 5 mm. Evidence: TAS. Frequency: Very frequent (HP:0040281). (ORPHA:529)
- Multiple lipomas (HP:0001012): The presence of multiple lipomas (a type of benign tissue made of fatty tissue). Evidence: TAS. Frequency: Frequent (HP:0040282). (ORPHA:529)
- Purpura (HP:0000979): Purpura (from Latin: purpura, meaning purple) is the appearance of red or purple discolorations on the skin that do not blanch on applying pressure. They are caused by bleeding underneath the skin. This term refers to an abnormally increased susceptibility to developing purpura. Purpura are larger than petechiae. Evidence: TAS. Frequency: Very rare (HP:0040284). (ORPHA:529)
- Thrombocytopenia (HP:0001873): A reduction in the number of circulating thrombocytes. Evidence: TAS. Frequency: Very rare (HP:0040284). (ORPHA:529)
These phenotypes are associated with the disease Roch-Leri mesosomatous lipomatosis (ORPHA:529).